- Irregularly shaped sperm tail (HP:0033393): Irregular or changing caliber (diameter) along the tail of the sperm. Evidence: PCS. Frequency: 4/4. (PMID:33472045)
- X-linked recessive inheritance (HP:0001419): A mode of inheritance that is observed for recessive traits related to a gene encoded on the X chromosome. In the context of medical genetics, X-linked recessive disorders manifest in males (who have one copy of the X chromosome and are thus hemizygotes), but generally not in female heterozygotes who have one mutant and one normal allele. Evidence: PCS. (PMID:33472045)
- Coiled sperm flagella (HP:0032560): Sperm cells whose flagella are twisted (coiled). Evidence: PCS. Frequency: 4/4. (PMID:33472045)
- Male infertility (HP:0003251). Evidence: PCS. Frequency: 4/4. (PMID:33472045)
- Reduced sperm motility (HP:0012207): An abnormal reduction in the mobility of ejaculated sperm. Evidence: PCS. Frequency: 4/4. (PMID:33472045)
- Absent sperm flagella (HP:0032558): Sperm cells lacking flagella. Evidence: PCS. Frequency: 4/4. (PMID:33472045)
- Oligozoospermia (HP:0000798): Reduced count of spermatozoa in the semen, defined as a sperm count below 20 million per milliliter semen. Evidence: PCS. Frequency: 4/4. (PMID:33472045)
- Short sperm flagella (HP:0032559): Sperm cells with abnormally short flagella. Evidence: PCS. Frequency: 4/4. (PMID:33472045)
These phenotypes are associated with the disease spermatogenic failure, X-linked, 3 (OMIM:301059).